- Sensory neuropathy (HP:0000763): Peripheral neuropathy affecting the sensory nerves. Evidence: TAS. Frequency: Very frequent (HP:0040281). (ORPHA:36258)
- Vasculitis (HP:0002633): Inflammation of blood vessel. Evidence: TAS. Frequency: Very frequent (HP:0040281). (ORPHA:36258)
- Arterial thrombosis (HP:0004420): The formation of a blood clot inside an artery. Evidence: TAS. Frequency: Very frequent (HP:0040281). (ORPHA:36258)
- Gangrene (HP:0100758): A serious and potentially life-threatening condition that arises when a considerable mass of body tissue dies (necrosis). Evidence: TAS. Frequency: Very frequent (HP:0040281). (ORPHA:36258)
- Skin ulcer (HP:0200042): A discontinuity of the skin exhibiting complete loss of the epidermis and often portions of the dermis and even subcutaneous fat. Evidence: TAS. Frequency: Very frequent (HP:0040281). (ORPHA:36258)
- Acrocyanosis (HP:0001063): Bluish discoloration of the skin of the hands or feet. Evidence: TAS. Frequency: Frequent (HP:0040282). (ORPHA:36258)
- Arthralgia (HP:0002829): Joint pain. Evidence: TAS. Frequency: Frequent (HP:0040282). (ORPHA:36258)
- Paresthesia (HP:0003401): Abnormal sensations such as tingling, pricking, or numbness of the skin with no apparent physical cause. Evidence: TAS. Frequency: Frequent (HP:0040282). (ORPHA:36258)
- Intermittent claudication (HP:0004417): Intermittent claudication is a symptom of peripheral arterial occlusive disease. After having walked over a distance which is individually characteristic, the patients experience pain or cramps in the calves, feet or thighs which typically subsides on standing still. Evidence: TAS. Frequency: Frequent (HP:0040282). (ORPHA:36258)
- Raynaud phenomenon (HP:0030880). Evidence: TAS. Frequency: Frequent (HP:0040282). (ORPHA:36258)
- Digital ischemia (HP:0033402): Restriction of arterial blood supply to a digit (finger or toe) associated with insufficient oxygenation to support the metabolic requirements of the digit. Clinical manifestations may include pain, pallor, lack of pulse, coldness, paresthesia, and paralysis. Evidence: TAS. Frequency: Frequent (HP:0040282). (ORPHA:36258)
- Livedo reticularis (HP:0033505): Livedo reticularis is characterized by the presence of a bluish purple, mottled or netlike pattern in unbroken circles on the skin. Exposure to cold environments usually intensifies the vascular pattern. Presumably, the condition results from slow or stagnant blood flow, vessel-wall pathology, and decreased oxygen tension. Evidence: TAS. Frequency: Frequent (HP:0040282). (ORPHA:36258)
- Hyperhidrosis (HP:0000975): Abnormal excessive perspiration (sweating) despite the lack of appropriate stimuli like hot and humid weather. Evidence: TAS. Frequency: Occasional (HP:0040283). (ORPHA:36258)
- Superficial thrombophlebitis (HP:0002638): Inflammation of a superficial vein associated with venous thrombosis (blood clot formation within the vein). Evidence: TAS. Frequency: Occasional (HP:0040283). (ORPHA:36258)
- Acroparesthesia (HP:0031006): A type of paresthesia (tingling, pins-and-needles, burning or numbness or stiffness) that occurs in the hands and feet and particularly in the fingers and toes. Evidence: TAS. Frequency: Occasional (HP:0040283). (ORPHA:36258)
- Insomnia (HP:0100785): Persistent difficulty in starting or maintaining sleep, or waking up earlier than desired, despite having adequate opportunities and conditions for sleep. Evidence: TAS. Frequency: Occasional (HP:0040283). (ORPHA:36258)
- Arterial occlusion (HP:0025324): Blockage of blood flow through an artery. Evidence: TAS. Frequency: Very rare (HP:0040284). (ORPHA:36258)
These phenotypes are associated with the disease Buerger disease (ORPHA:36258).